Phenotypes associated with the disease spermatogenic failure 35 (OMIM:618341):
- Coiled sperm flagella (HP:0032560): Sperm cells whose flagella are twisted (coiled). Evidence: PCS. Frequency: 2/2. (PMID:30683861)
- Male infertility (HP:0003251). Evidence: PCS. Frequency: 2/2. (PMID:30683861)
- Young adult onset (HP:0011462): Onset of disease at the age of between 16 and 40 years. Evidence: PCS. Frequency: 2/2. (PMID:30683861)
- Autosomal recessive inheritance (HP:0000007): A mode of inheritance that is observed for traits related to a gene encoded on one of the autosomes (i.e., the human chromosomes 1-22) in which a trait manifests in individuals with two pathogenic alleles, either homozygotes (two copies of the same mutant allele) or compound heterozygotes (whereby each copy of a gene has a distinct mutant allele). Evidence: PCS. (PMID:30683861)
- Absent sperm axoneme central pair complex (HP:0033525): Absence of the central pair of microtubules in the sperm axoneme, thereby forming a 9+0 pattern instead of the normal 9+2 pattern. Evidence: PCS. Frequency: 1/2. (PMID:30683861)
- Absent sperm flagella (HP:0032558): Sperm cells lacking flagella. Evidence: PCS. Frequency: 2/2. (PMID:30683861)
- Short sperm flagella (HP:0032559): Sperm cells with abnormally short flagella. Evidence: PCS. Frequency: 2/2. (PMID:30683861)